- Autosomal recessive inheritance (HP:0000007): A mode of inheritance that is observed for traits related to a gene encoded on one of the autosomes (i.e., the human chromosomes 1-22) in which a trait manifests in individuals with two pathogenic alleles, either homozygotes (two copies of the same mutant allele) or compound heterozygotes (whereby each copy of a gene has a distinct mutant allele). Evidence: PCS. (PMID:21734151)
- Intellectual disability (HP:0001249): The term intellectual disability or intellectual developmental disorder is used to describe significantly sub-average intellectual and adaptive functioning based on clinical assessment and as measured by individually administered, appropriately normed, standardized and validated tests of intellectual functioning and adaptive behavior, with onset during the developmental period from infancy through adolescence. Evidence: PCS. Frequency: 6/6. (PMID:21734151)
These phenotypes are associated with the disease intellectual disability, autosomal recessive 56 (OMIM:617125).